- Epicanthus (HP:0000286): A fold of skin starting above the medial aspect of the upper eyelid and arching downward to cover, pass in front of and lateral to the medial canthus. Evidence: PCS. Frequency: 2/2. (PMID:34805998)
- Narrow mouth (HP:0000160): Distance between the commissures of the mouth more than 2 SD below the mean. Alternatively, an apparently decreased width of the oral aperture (subjective). Evidence: PCS. Frequency: 2/2. (PMID:34805998)
- Gait ataxia (HP:0002066): A type of ataxia characterized by the impairment of the ability to coordinate the movements required for normal walking. Gait ataxia is characteirzed by a wide-based staggering gait with a tendency to fall. Evidence: PCS. Frequency: 1/2. (PMID:34805998)
- Low posterior hairline (HP:0002162): Hair on the neck extends more inferiorly than usual. Evidence: PCS. Frequency: 2/2. (PMID:34805998)
- Hypotonia (HP:0001252): Hypotonia is an abnormally low muscle tone (the amount of tension or resistance to movement in a muscle). Even when relaxed, muscles have a continuous and passive partial contraction which provides some resistance to passive stretching. Hypotonia thus manifests as diminished resistance to passive stretching. Hypotonia is not the same as muscle weakness, although the two conditions can co-exist. Evidence: PCS. Frequency: 2/2. (PMID:34805998)
- Infantile onset (HP:0003593): Onset of signs or symptoms of disease between 28 days to one year of life. Evidence: PCS. Frequency: 1/1. (PMID:34805998)
- Chronic constipation (HP:0012450): Constipation for longer than three months with fewer than 3 bowel movements per week, straining, lumpy or hard stools, and a sensation of anorectal obstruction or incomplete defecation. Evidence: PCS. Frequency: 2/2. (PMID:34805998)
- Hypertelorism (HP:0000316): Interpupillary distance more than 2 SD above the mean (alternatively, the appearance of an increased interpupillary distance or widely spaced eyes). Evidence: PCS. Frequency: 2/2. (PMID:34805998)
- Thin upper lip vermilion (HP:0000219): Height of the vermilion of the upper lip in the midline more than 2 SD below the mean. Alternatively, an apparently reduced height of the vermilion of the upper lip in the frontal view (subjective). Evidence: PCS. Frequency: 2/2. (PMID:34805998)
- Protruding ear (HP:0000411): Angle formed by the plane of the ear and the mastoid bone greater than the 97th centile for age (objective); or, outer edge of the helix more than 2 cm from the mastoid at the point of maximum distance (objective). Evidence: PCS. Frequency: 2/2. (PMID:34805998)
- Proximal muscle weakness (HP:0003701): A lack of strength of the proximal muscles. Evidence: PCS. Frequency: 2/2. (PMID:34805998)
- Axial muscle weakness (HP:0003327): Reduced strength of the axial musculature (i.e., of the muscles of the head and neck, spine, and ribs). Evidence: PCS. Frequency: 2/2. (PMID:34805998)
- Retrognathia (HP:0000278): An abnormality in which the mandible is mislocalised posteriorly. Evidence: PCS. Frequency: 1/2. (PMID:34805998)
- Diastema (HP:0000699): Increased space between two adjacent teeth in the same dental arch. Evidence: PCS. Frequency: 1/2. (PMID:34805998)
- Highly arched eyebrow (HP:0002553): Increased height of the central portion of the eyebrow, forming a crescent, semicircular, or inverted U shape. Evidence: PCS. Frequency: 2/2. (PMID:34805998)
- Lateral ventricle dilatation (HP:0006956). Evidence: PCS. Frequency: 1/1. (PMID:34805998)
- Loud snoring (HP:0025372): Snoring at a particularly loud or abnormally high volume. Evidence: PCS. Frequency: 2/2. (PMID:34805998)
- Feeding difficulties (HP:0011968): Impaired ability to eat related to problems gathering food and getting ready to suck, chew, or swallow it. Evidence: PCS. Frequency: 2/2. (PMID:34805998)
- Global developmental delay (HP:0001263): A delay in the achievement of motor or mental milestones in the domains of development of a child, including motor skills, speech and language, cognitive skills, and social and emotional skills. This term should only be used to describe children younger than five years of age. Evidence: PCS. Frequency: 1/2. (PMID:34805998)
- Tapered finger (HP:0001182): The gradual reduction in girth of the finger from proximal to distal. Evidence: PCS. Frequency: 1/2. (PMID:34805998)
- Fatigue (HP:0012378): A subjective feeling of tiredness characterized by a lack of energy and motivation. Evidence: PCS. Frequency: 1/2. (PMID:34805998)
- Sleep apnea (HP:0010535): An intermittent cessation of airflow at the mouth and nose during sleep is known as sleep apnea. Apneas that last at least 10 seconds are considered significant, but individuals with sleep apnea may experience apneas lasting from 20 seconds up to 2 or 3 minutes. Patients may have up to 15 events per hour of sleep. Evidence: PCS. Frequency: 1/1. (PMID:34805998)
- Reduced cerebral white matter volume (HP:0034295): An abnormally low volume of the white matter of the brain. Evidence: PCS. Frequency: 1/1. (PMID:34805998)
- Sensorineural hearing impairment (HP:0000407): A type of hearing impairment in one or both ears related to an abnormal functionality of the cochlear nerve. Evidence: PCS. Frequency: 2/2. (PMID:34805998)
- Ptosis (HP:0000508): The upper eyelid margin is positioned 3 mm or more lower than usual and covers the superior portion of the iris (objective); or, the upper lid margin obscures at least part of the pupil (subjective). Evidence: PCS. Frequency: 2/2. (PMID:34805998)
- Peg-shaped maxillary lateral incisors (HP:0006342): A tooth crown with its mesial and distal sides converging or tapering toward the incisal edge causing severe reduction of mesiodistal diameter. Evidence: PCS. Frequency: 2/2. (PMID:34805998)
- Autosomal recessive inheritance (HP:0000007): A mode of inheritance that is observed for traits related to a gene encoded on one of the autosomes (i.e., the human chromosomes 1-22) in which a trait manifests in individuals with two pathogenic alleles, either homozygotes (two copies of the same mutant allele) or compound heterozygotes (whereby each copy of a gene has a distinct mutant allele). Evidence: PCS. (PMID:34805998)
- Self-injurious behavior (HP:0100716): Self-aggression. Evidence: PCS. Frequency: 1/2. (PMID:34805998)
- Low-set ears (HP:0000369): Upper insertion of the ear to the scalp below an imaginary horizontal line drawn between the inner canthi of the eye and extending posteriorly to the ear. Evidence: PCS. Frequency: 2/2. (PMID:34805998)
These phenotypes are associated with the disease auroneurodental syndrome (OMIM:620830).